Phenotypes associated with the disease Stargardt disease 4 (OMIM:603786):
- Retinal flecks (HP:0012045): Presence of multiple yellowish-white lesions of various size and configuration on the retina not related to vascular lesions. Evidence: TAS. (OMIM:603786)
- Macular degeneration (HP:0000608): A nonspecific term denoting degeneration of the retinal pigment epithelium and/or retinal photoreceptor cells of the macula lutea. Evidence: TAS. (OMIM:603786)
- Reduced visual acuity (HP:0007663). Evidence: TAS. (OMIM:603786)
- Autosomal dominant inheritance (HP:0000006): A mode of inheritance that is observed for traits related to a gene encoded on one of the autosomes (i.e., the human chromosomes 1-22) in which a trait manifests in heterozygotes. In the context of medical genetics, an autosomal dominant disorder is caused when a single copy of the mutant allele is present. Males and females are affected equally, and can both transmit the disorder with a risk of 50% for each child of inheriting the mutant allele. Evidence: TAS. (OMIM:603786)